Phenotypes associated with the disease Eosinophilic gastroenteritis (ORPHA:2070):
- Increased total eosinophil count (HP:0001880): Increased count of eosinophils in the blood. Evidence: TAS. Frequency: Very frequent (HP:0040281). (ORPHA:2070)
- Anemia (HP:0001903): A reduction in erythrocytes volume or hemoglobin concentration. Evidence: TAS. Frequency: Frequent (HP:0040282). (ORPHA:2070)
- Increased total leukocyte count (HP:0001974): An abnormal increase in the number of leukocytes in the blood. Evidence: TAS. Frequency: Frequent (HP:0040282). (ORPHA:2070)
- Vomiting (HP:0002013): Forceful ejection of the contents of the stomach through the mouth by means of a series of involuntary spasmic contractions. Evidence: TAS. Frequency: Frequent (HP:0040282). (ORPHA:2070)
- Diarrhea (HP:0002014): Abnormally increased frequency (usually defined as three or more) loose or watery bowel movements a day. Evidence: TAS. Frequency: Frequent (HP:0040282). (ORPHA:2070)
- Dysphagia (HP:0002015): Difficulty in swallowing. Evidence: TAS. Frequency: Frequent (HP:0040282). (ORPHA:2070)
- Malabsorption (HP:0002024): Impaired ability to absorb one or more nutrients from the intestine. Evidence: TAS. Frequency: Frequent (HP:0040282). (ORPHA:2070)
- Abdominal pain (HP:0002027): An unpleasant sensation characterized by physical discomfort (such as pricking, throbbing, or aching) and perceived to originate in the abdomen. Evidence: TAS. Frequency: Frequent (HP:0040282). (ORPHA:2070)
- Steatorrhea (HP:0002570): Greater than normal amounts of fat in the feces. This is a result of malabsorption of lipids in the small intestine and results in frothy foul-smelling fecal matter that floats. Evidence: TAS. Frequency: Frequent (HP:0040282). (ORPHA:2070)
- Hypoalbuminemia (HP:0003073): The concentration of albumin in the blood circulation is below the lower limit of normal. Evidence: TAS. Frequency: Frequent (HP:0040282). (ORPHA:2070)
- Allergic rhinitis (HP:0003193): It is characterized by one or more symptoms including sneezing, itching, nasal congestion, and rhinorrhea. Evidence: TAS. Frequency: Frequent (HP:0040282). (ORPHA:2070)
- Abnormality of the gastrointestinal tract (HP:0011024): An abnormality of the gastrointestinal tract. Evidence: TAS. Frequency: Frequent (HP:0040282). (ORPHA:2070)
- Elevated circulating C-reactive protein concentration (HP:0011227): The concentration of C-reactive protein in the blood circulation is above the upper limit of normal. Evidence: TAS. Frequency: Frequent (HP:0040282). (ORPHA:2070)
- Edema (HP:0000969): An abnormal accumulation of fluid beneath the skin, or in one or more cavities of the body. Evidence: TAS. Frequency: Occasional (HP:0040283). (ORPHA:2070)
- Atopic dermatitis (HP:0001047): Atopic dermatitis (AD) or atopic eczema is an itchy, inflammatory skin condition with a predilection for the skin flexures. It is characterized by poorly defined erythema with edema, vesicles, and weeping in the acute stage and skin thickening (lichenification) in the chronic stage. Evidence: TAS. Frequency: Occasional (HP:0040283). (ORPHA:2070)
- Ascites (HP:0001541): Accumulation of fluid in the peritoneal cavity (between the layers of the peritoneum that lines the abdomen). Evidence: TAS. Frequency: Occasional (HP:0040283). (ORPHA:2070)
- Weight loss (HP:0001824): Reduction of total body weight. Evidence: TAS. Frequency: Occasional (HP:0040283). (ORPHA:2070)
- Asthma (HP:0002099): Asthma is characterized by increased responsiveness of the tracheobronchial tree to multiple stimuli, leading to narrowing of the air passages with resultant dyspnea, cough, and wheezing. Evidence: TAS. Frequency: Occasional (HP:0040283). (ORPHA:2070)
- Protein-losing enteropathy (HP:0002243): Abnormal loss of protein from the digestive tract related to excessive leakage of plasma proteins into the lumen of the gastrointestinal tract. Evidence: TAS. Frequency: Occasional (HP:0040283). (ORPHA:2070)
- Hematochezia (HP:0002573): The passage of fresh (red) blood per anus, usually in or with stools. Most rectal bleeding comes from the colon, rectum, or anus. Evidence: TAS. Frequency: Occasional (HP:0040283). (ORPHA:2070)
- Elevated erythrocyte sedimentation rate (HP:0003565): An increased erythrocyte sedimentation rate (ESR). The ESR is a test that measures the distance that erythrocytes have fallen after one hour in a vertical column of anticoagulated blood under the influence of gravity. The ESR is a nonspecific finding. An elevation may indicate inflammation or may be caused by any condition that elevates fibrinogen. Evidence: TAS. Frequency: Occasional (HP:0040283). (ORPHA:2070)